- Facial myokymia (HP:0000317): Facial myokymia is a fine fibrillary activity of one or more muscles innervated by the facial nerve (the seventh cranial nerve). Evidence: TAS. Frequency: Very frequent (HP:0040281). (ORPHA:324588)
- Orofacial dyskinesia (HP:0002310). Evidence: TAS. Frequency: Very frequent (HP:0040281). (ORPHA:324588)
- Dysarthria (HP:0001260): Dysarthric speech is a general description referring to a neurological speech disorder characterized by poor articulation. Depending on the involved neurological structures, dysarthria may be further classified as spastic, flaccid, ataxic, hyperkinetic and hypokinetic, or mixed. Evidence: TAS. Frequency: Frequent (HP:0040282). (ORPHA:324588)
- Gait disturbance (HP:0001288): The term gait disturbance can refer to any disruption of the ability to walk. Evidence: TAS. Frequency: Frequent (HP:0040282). (ORPHA:324588)
- Dystonia (HP:0001332): An abnormally increased muscular tone that causes fixed abnormal postures. There is a slow, intermittent twisting motion that leads to exaggerated turning and posture of the extremities and trunk. Evidence: TAS. Frequency: Frequent (HP:0040282). (ORPHA:324588)
- Myoclonus (HP:0001336): Very brief, involuntary random muscular contractions occurring at rest, in response to sensory stimuli, or accompanying voluntary movements. Evidence: TAS. Frequency: Frequent (HP:0040282). (ORPHA:324588)
- Chorea (HP:0002072): Chorea (Greek for 'dance') refers to widespread arrhythmic involuntary movements of a forcible, jerky and restless fashion. It is a random-appearing sequence of one or more discrete involuntary movements or movement fragments. Movements appear random because of variability in timing, duration or location. Each movement may have a distinct start and end. However, movements may be strung together and thus may appear to flow randomly from one muscle group to another. Chorea can involve the trunk, neck, face, tongue, and extremities. Evidence: TAS. Frequency: Frequent (HP:0040282). (ORPHA:324588)
- Resting tremor (HP:0002322): A resting tremor occurs when muscles are at rest and becomes less noticeable or disappears when the affected muscles are moved. Resting tremors are often slow and coarse. Evidence: TAS. Frequency: Frequent (HP:0040282). (ORPHA:324588)
- Limb hypertonia (HP:0002509). Evidence: TAS. Frequency: Frequent (HP:0040282). (ORPHA:324588)
- Axial hypotonia (HP:0008936): Muscular hypotonia (abnormally low muscle tone) affecting the musculature of the trunk. Evidence: TAS. Frequency: Frequent (HP:0040282). (ORPHA:324588)
- Hyperreflexia (HP:0001347): Hyperreflexia is the presence of hyperactive stretch reflexes of the muscles. Evidence: TAS. Frequency: Occasional (HP:0040283). (ORPHA:324588)
- Congestive heart failure (HP:0001635): The presence of an abnormality of cardiac function that is responsible for the failure of the heart to pump blood at a rate that is commensurate with the needs of the tissues or a state in which abnormally elevated filling pressures are required for the heart to do so. Heart failure is frequently related to a defect in myocardial contraction. Evidence: TAS. Frequency: Occasional (HP:0040283). (ORPHA:324588)
- Dilated cardiomyopathy (HP:0001644): Dilated cardiomyopathy (DCM) is defined by the presence of left ventricular dilatation and left ventricular systolic dysfunction in the absence of abnormal loading conditions (hypertension, valve disease) or coronary artery disease sufficient to cause global systolic impairment. Right ventricular dilation and dysfunction may be present but are not necessary for the diagnosis. Evidence: TAS. Frequency: Occasional (HP:0040283). (ORPHA:324588)
- Delayed gross motor development (HP:0002194): A type of motor delay characterized by a delay in acquiring the ability to control the large muscles of the body for walking, running, sitting, and crawling. Evidence: TAS. Frequency: Occasional (HP:0040283). (ORPHA:324588)
These phenotypes are associated with the disease Familial dyskinesia and facial myokymia (ORPHA:324588).
The following phenotypes are NOT associated with this disease:
- Intellectual disability (HP:0001249): The term intellectual disability or intellectual developmental disorder is used to describe significantly sub-average intellectual and adaptive functioning based on clinical assessment and as measured by individually administered, appropriately normed, standardized and validated tests of intellectual functioning and adaptive behavior, with onset during the developmental period from infancy through adolescence. Evidence: TAS. (ORPHA:324588)